Phenotypes associated with the disease Jervell and Lange-Nielsen syndrome 2 (OMIM:612347):
- Congenital onset (HP:0003577): A phenotypic abnormality that is present at birth. Evidence: PCS. Frequency: 1/1. (PMID:9445165)
- Premature ventricular contraction (HP:0006682): Premature ventricular contractions (PVC) or ventricular extrasystoles are premature contractions of the heart that arise in response to an impulse in the ventricles rather than the normal impulse from the sinoatrial (SA) node. Evidence: PCS. Frequency: 1/1. (PMID:9445165)
- Autosomal recessive inheritance (HP:0000007): A mode of inheritance that is observed for traits related to a gene encoded on one of the autosomes (i.e., the human chromosomes 1-22) in which a trait manifests in individuals with two pathogenic alleles, either homozygotes (two copies of the same mutant allele) or compound heterozygotes (whereby each copy of a gene has a distinct mutant allele). Evidence: PCS. (PMID:9445165)
- Prolonged QT interval (HP:0001657): Increased time between the start of the Q wave and the end of the T wave as measured by the electrocardiogram (EKG). Evidence: PCS. Frequency: 1/1. (PMID:9445165)
- Syncope (HP:0001279): A transient loss of consciousness (i.e., characterized by a rapid onset, a short duration, and a spontaneous and complete recovery) due to cerebral hypoperfusion. Evidence: PCS. Frequency: 1/1. (PMID:9445165)
- Torsade de pointes (HP:0001664): A type of ventricular tachycardia characterized by polymorphioc QRS complexes that change in amplitue and cycle length, and thus have the appearance of oscillating around the baseline in the EKG. Evidence: TAS. (OMIM:612347)
- Congenital sensorineural hearing impairment (HP:0008527): A type of hearing impairment caused by an abnormal functionality of the cochlear nerve with congenital onset. Evidence: PCS. Frequency: 1/1. (PMID:9445165)
- Sudden cardiac death (HP:0001645): The heart suddenly and unexpectedly stops beating resulting in death within a short time period (generally within 1 h of symptom onset). Evidence: TAS. (OMIM:612347)